Phenotypes associated with the disease X-linked Ehlers-Danlos syndrome (ORPHA:75497):
- Joint hypermobility (HP:0001382): The capability that a joint (or a group of joints) has to move, passively and/or actively, beyond normal limits along physiological axes. Evidence: TAS. Frequency: Very frequent (HP:0040281). (ORPHA:75497)
- Inguinal hernia (HP:0000023): Protrusion of the contents of the abdominal cavity through the inguinal canal. Evidence: TAS. Frequency: Very frequent (HP:0040281). (ORPHA:75497)
- Thin skin (HP:0000963): Reduction in thickness of the skin, generally associated with a loss of suppleness and elasticity of the skin. Evidence: TAS. Frequency: Very frequent (HP:0040281). (ORPHA:75497)
- Hyperextensible skin (HP:0000974): A condition in which the skin can be stretched beyond normal, and then returns to its initial position. Evidence: TAS. Frequency: Very frequent (HP:0040281). (ORPHA:75497)
- Bruising susceptibility (HP:0000978): An ecchymosis (bruise) refers to the skin discoloration caused by the escape of blood into the tissues from ruptured blood vessels. This term refers to an abnormally increased susceptibility to bruising. The corresponding phenotypic abnormality is generally elicited on medical history as a report of frequent ecchymoses or bruising without adequate trauma. Evidence: TAS. Frequency: Very frequent (HP:0040281). (ORPHA:75497)
- Umbilical hernia (HP:0001537): Protrusion of abdominal contents through a defect in the abdominal wall musculature around the umbilicus. Skin and subcutaneous tissue overlie the defect. Evidence: TAS. Frequency: Very frequent (HP:0040281). (ORPHA:75497)
- Gastroesophageal reflux (HP:0002020): A condition in which the stomach contents leak backwards from the stomach into the esophagus through the lower esophageal sphincter. Evidence: TAS. Frequency: Very frequent (HP:0040281). (ORPHA:75497)
- Short stature (HP:0004322): A height below that which is expected according to age and gender norms. Although there is no universally accepted definition of short stature, many refer to "short stature" as height more than 2 standard deviations below the mean for age and gender (or below the 3rd percentile for age and gender dependent norms). Evidence: TAS. Frequency: Very frequent (HP:0040281). (ORPHA:75497)
- Abnormal cardiovascular system morphology (HP:0030680): Any structural anomaly of the heart and blood vessels. Evidence: TAS. Frequency: Very frequent (HP:0040281). (ORPHA:75497)
- Hernia (HP:0100790). Evidence: TAS. Frequency: Very frequent (HP:0040281). (ORPHA:75497)